- Carious teeth (HP:0000670): Caries is a multifactorial bacterial infection affecting the structure of the tooth. This term has been used to describe the presence of more than expected dental caries. Evidence: TAS. (OMIM:204700)
- Amelogenesis imperfecta (HP:0000705): A developmental dysplasia of the dental enamel. Evidence: PCS. Frequency: 2/2. (PMID:15235027)
- Anterior open-bite malocclusion (HP:0009102): Anterior open bite is a malocclusion characterized by a gap between the anterior teeth (incisors), that is, by a deficiency in the normal vertical overlap between antagonist incisal edges when the posterior teeth are in occlusion. Evidence: PCS. Frequency: 1/2. (PMID:15235027)
- Enamel hypomineralization (HP:0006285): A decreased amount of enamel mineralization. Hypomineralized enamel has a brown discoloration and brittle aspect. Evidence: PCS. Frequency: 2/2. (PMID:15235027)
- Yellow-brown discoloration of the teeth (HP:0006286). Evidence: PCS. Frequency: 2/2. (PMID:15235027)
- Infantile onset (HP:0003593): Onset of signs or symptoms of disease between 28 days to one year of life. Evidence: PCS. Frequency: 2/2. (PMID:15235027)
- Autosomal recessive inheritance (HP:0000007): A mode of inheritance that is observed for traits related to a gene encoded on one of the autosomes (i.e., the human chromosomes 1-22) in which a trait manifests in individuals with two pathogenic alleles, either homozygotes (two copies of the same mutant allele) or compound heterozygotes (whereby each copy of a gene has a distinct mutant allele). Evidence: PCS. (PMID:15235027)
These phenotypes are associated with the disease amelogenesis imperfecta type 2A1 (OMIM:204700).